- Thrombocytopenia (HP:0001873, a Human Phenotype Ontology term): A reduction in the number of circulating thrombocytes. Evidence: TAS. Frequency: Frequent (HP:0040282, a Human Phenotype Ontology term). (ORPHA:90038)
- Acute kidney injury (HP:0001919, a Human Phenotype Ontology term): Sudden loss of renal function, as manifested by decreased urine production, and a rise in serum creatinine or blood urea nitrogen concentration (azotemia). Evidence: TAS. Frequency: Frequent (HP:0040282, a Human Phenotype Ontology term). (ORPHA:90038)
- Microangiopathic hemolytic anemia (HP:0001937, a Human Phenotype Ontology term). Evidence: TAS. Frequency: Frequent (HP:0040282, a Human Phenotype Ontology term). (ORPHA:90038)
- Vomiting (HP:0002013, a Human Phenotype Ontology term): Forceful ejection of the contents of the stomach through the mouth by means of a series of involuntary spasmic contractions. Evidence: TAS. Frequency: Frequent (HP:0040282, a Human Phenotype Ontology term). (ORPHA:90038)
- Diarrhea (HP:0002014, a Human Phenotype Ontology term): Abnormally increased frequency (usually defined as three or more) loose or watery bowel movements a day. Evidence: TAS. Frequency: Frequent (HP:0040282, a Human Phenotype Ontology term). (ORPHA:90038)
- Abdominal pain (HP:0002027, a Human Phenotype Ontology term): An unpleasant sensation characterized by physical discomfort (such as pricking, throbbing, or aching) and perceived to originate in the abdomen. Evidence: TAS. Frequency: Frequent (HP:0040282, a Human Phenotype Ontology term). (ORPHA:90038)
- Elevated circulating creatinine concentration (HP:0003259, a Human Phenotype Ontology term): An increased amount of creatinine in the blood. Evidence: TAS. Frequency: Frequent (HP:0040282, a Human Phenotype Ontology term). (ORPHA:90038)
- Dysfunctional alternative complement pathway (HP:0005423, a Human Phenotype Ontology term): An abnormality of the functioning of any aspect of the alternative complement pathway. Evidence: TAS. Frequency: Frequent (HP:0040282, a Human Phenotype Ontology term). (ORPHA:90038)
- Unconjugated hyperbilirubinemia (HP:0008282, a Human Phenotype Ontology term): An increased amount of unconjugated (indirect) bilurubin in the blood. Evidence: TAS. Frequency: Frequent (HP:0040282, a Human Phenotype Ontology term). (ORPHA:90038)
- Anuria (HP:0100519, a Human Phenotype Ontology term): Absence of urine, clinically classified as below 50ml/day. Evidence: TAS. Frequency: Frequent (HP:0040282, a Human Phenotype Ontology term). (ORPHA:90038)
- Abnormality of the nervous system (HP:0000707, a Human Phenotype Ontology term): An abnormality of the nervous system. Evidence: TAS. Frequency: Occasional (HP:0040283, a Human Phenotype Ontology term). (ORPHA:90038)
- Irritability (HP:0000737, a Human Phenotype Ontology term): An emotional state characterized by negative feelings of heightened frustration, annoyance, or feeling upset, often triggered by internal factors (e.g., fatigue, hunger, unfulfilled desires) or external factors (e.g., social or environmental challenges). Irritability may be unpredictable, and is accompanied by a lowered threshold for emotional reactivity and observable features (speech, facial expressions, or psychomotor activity). Evidence: TAS. Frequency: Occasional (HP:0040283, a Human Phenotype Ontology term). (ORPHA:90038)
- Hypertension (HP:0000822, a Human Phenotype Ontology term): The presence of chronic increased pressure in the systemic arterial system. Evidence: TAS. Frequency: Occasional (HP:0040283, a Human Phenotype Ontology term). (ORPHA:90038)
- Seizure (HP:0001250, a Human Phenotype Ontology term): A seizure is an intermittent abnormality of nervous system physiology characterized by a transient occurrence of signs and/or symptoms due to abnormal excessive or synchronous neuronal activity in the brain. Evidence: TAS. Frequency: Occasional (HP:0040283, a Human Phenotype Ontology term). (ORPHA:90038)
- Excessive daytime somnolence (HP:0001262, a Human Phenotype Ontology term): A state of abnormally strong desire for sleep during the daytime. Evidence: TAS. Frequency: Occasional (HP:0040283, a Human Phenotype Ontology term). (ORPHA:90038)
- Reticulocytosis (HP:0001923, a Human Phenotype Ontology term): An elevation in the number of reticulocytes (immature erythrocytes) in the peripheral blood circulation. Evidence: TAS. Frequency: Occasional (HP:0040283, a Human Phenotype Ontology term). (ORPHA:90038)
- Dehydration (HP:0001944, a Human Phenotype Ontology term). Evidence: TAS. Frequency: Occasional (HP:0040283, a Human Phenotype Ontology term). (ORPHA:90038)
- Increased total leukocyte count (HP:0001974, a Human Phenotype Ontology term): An abnormal increase in the number of leukocytes in the blood. Evidence: TAS. Frequency: Occasional (HP:0040283, a Human Phenotype Ontology term). (ORPHA:90038)
- Schistocytosis (HP:0001981, a Human Phenotype Ontology term): The presence of an abnormal number of fragmented red blood cells (schistocytes) in the blood. Evidence: TAS. Frequency: Occasional (HP:0040283, a Human Phenotype Ontology term). (ORPHA:90038)
- Hypokalemia (HP:0002900, a Human Phenotype Ontology term): The concentration of potassium(1+) in the blood circulation is below the lower limit of normal. Evidence: TAS. Frequency: Occasional (HP:0040283, a Human Phenotype Ontology term). (ORPHA:90038)
- Hyponatremia (HP:0002902, a Human Phenotype Ontology term): The concentration of sodium in the blood circulation is below the lower limit of normal. Evidence: TAS. Frequency: Occasional (HP:0040283, a Human Phenotype Ontology term). (ORPHA:90038)
- Hemoglobinuria (HP:0003641, a Human Phenotype Ontology term): The presence of free hemoglobin in the urine. Evidence: TAS. Frequency: Occasional (HP:0040283, a Human Phenotype Ontology term). (ORPHA:90038)
- Bloody diarrhea (HP:0025085, a Human Phenotype Ontology term): Passage of many stools containing blood. Evidence: TAS. Frequency: Occasional (HP:0040283, a Human Phenotype Ontology term). (ORPHA:90038)
- Increased circulating lactate dehydrogenase concentration (HP:0025435, a Human Phenotype Ontology term): An elevated level of the enzyme lactate dehydrogenase in the blood circulation. Evidence: TAS. Frequency: Occasional (HP:0040283, a Human Phenotype Ontology term). (ORPHA:90038)
- Intestinal perforation (HP:0031368, a Human Phenotype Ontology term): A hole (perforation) in the wall of the intestine. Evidence: TAS. Frequency: Occasional (HP:0040283, a Human Phenotype Ontology term). (ORPHA:90038)
- Acute colitis (HP:0100282, a Human Phenotype Ontology term): An acute and self-limited inflammatory disease of the large intestine (colon, cecum and rectum). Evidence: TAS. Frequency: Occasional (HP:0040283, a Human Phenotype Ontology term). (ORPHA:90038)
- Coma (HP:0001259, a Human Phenotype Ontology term): The complete absence of wakefulness and consciousness, which is evident through a lack of response to any form of external stimuli. Evidence: TAS. Frequency: Very rare (HP:0040284, a Human Phenotype Ontology term). (ORPHA:90038)
- Myocardial infarction (HP:0001658, a Human Phenotype Ontology term): Necrosis of the myocardium caused by an obstruction of the blood supply to the heart and often associated with chest pain, shortness of breath, palpitations, and anxiety as well as characteristic EKG findings and elevation of serum markers including creatine kinase-MB fraction and troponin. Evidence: TAS. Frequency: Very rare (HP:0040284, a Human Phenotype Ontology term). (ORPHA:90038)
- Pancreatitis (HP:0001733, a Human Phenotype Ontology term): The presence of inflammation in the pancreas. Evidence: TAS. Frequency: Very rare (HP:0040284, a Human Phenotype Ontology term). (ORPHA:90038)
- Rectal prolapse (HP:0002035, a Human Phenotype Ontology term): Protrusion of the rectal mucous membrane through the anus. Evidence: TAS. Frequency: Very rare (HP:0040284, a Human Phenotype Ontology term). (ORPHA:90038)
- Intussusception (HP:0002576, a Human Phenotype Ontology term): An abnormality of the intestine in which part of the intestine invaginates (telescopes) into another part of the intestine. Evidence: TAS. Frequency: Very rare (HP:0040284, a Human Phenotype Ontology term). (ORPHA:90038)
- Peritonitis (HP:0002586, a Human Phenotype Ontology term): Inflammation of the peritoneum. Evidence: TAS. Frequency: Very rare (HP:0040284, a Human Phenotype Ontology term). (ORPHA:90038)
- Colonic stenosis (HP:0012851, a Human Phenotype Ontology term): A narrowing of a segment of colon whereby bowel continuity is maintained. Evidence: TAS. Frequency: Very rare (HP:0040284, a Human Phenotype Ontology term). (ORPHA:90038)
These phenotypes are associated with the disease Shiga toxin-associated hemolytic uremic syndrome (ORPHA:90038, an Orphanet rare-disease identifier).